- Sensorineural hearing impairment (HP:0000407): A type of hearing impairment in one or both ears related to an abnormal functionality of the cochlear nerve. Evidence: PCS. Onset: Congenital onset (HP:0003577). (PMID:12719379)
- Autosomal recessive inheritance (HP:0000007): A mode of inheritance that is observed for traits related to a gene encoded on one of the autosomes (i.e., the human chromosomes 1-22) in which a trait manifests in individuals with two pathogenic alleles, either homozygotes (two copies of the same mutant allele) or compound heterozygotes (whereby each copy of a gene has a distinct mutant allele). Evidence: PCS. (PMID:12719379)
These phenotypes are associated with the disease autosomal recessive nonsyndromic hearing loss 61 (OMIM:613865).